- Delayed epiphyseal ossification (HP:0002663). Evidence: IEA. (OMIM:300009)
- Nephrocalcinosis (HP:0000121): Nephrocalcinosis is the deposition of calcium salts in renal parenchyma. Evidence: PCS. Frequency: 9/28. (PMID:8559248)
- Tibial bowing (HP:0002982): A bending or abnormal curvature of the tibia. Evidence: TAS. (OMIM:300009)
- Stage 5 chronic kidney disease (HP:0003774): A degree of kidney failure severe enough to require dialysis or kidney transplantation for survival characterized by a severe reduction in glomerular filtration rate (less than 15 ml/min/1.73 m2) and other manifestations including increased serum creatinine. Evidence: PCS. Frequency: 2/28. (PMID:8559248)
- Bulging epiphyses (HP:0003013): A morphological abnormality of epiphyses whereby they are abnormally outwardly curving (protuberant). Evidence: IEA. (OMIM:300009)
- Femoral bowing (HP:0002980): Bowing (abnormal curvature) of the femur. Evidence: TAS. (OMIM:300009)
- Aminoaciduria (HP:0003355): An increased concentration of an amino acid in the urine. Evidence: IEA. (OMIM:300009)
- Short stature (HP:0004322): A height below that which is expected according to age and gender norms. Although there is no universally accepted definition of short stature, many refer to "short stature" as height more than 2 standard deviations below the mean for age and gender (or below the 3rd percentile for age and gender dependent norms). Evidence: IEA. (OMIM:300009)
- Renal insufficiency (HP:0000083): A reduction in the level of performance of the kidneys in areas of function comprising the concentration of urine, removal of wastes, the maintenance of electrolyte balance, homeostasis of blood pressure, and calcium metabolism. Evidence: TAS. Onset: Adult onset (HP:0003581). (OMIM:300009)
- Glycosuria (HP:0003076): An increased concentration of glucose in the urine. Evidence: IEA. (OMIM:300009)
- Chronic kidney disease (HP:0012622): Functional anomaly of the kidney persisting for at least three months. Evidence: TAS. (OMIM:300009)
- Fibular bowing (HP:0010502): A bending or abnormal curvature of the fibula. Evidence: TAS. (OMIM:300009)
- Bowing of the legs (HP:0002979): A bending or abnormal curvature affecting a long bone of the leg. Evidence: IEA. (OMIM:300009)
- Renal phosphate wasting (HP:0000117): High urine phosphate in the presence of hypophosphatemia. Evidence: IEA. (OMIM:300009)
- Hyperphosphaturia (HP:0003109): An increased excretion of phosphates in the urine. Evidence: IEA. (OMIM:300009)
- Recurrent fractures (HP:0002757): The repeated occurrence of bone fractures (implying an abnormally increased tendency for fracture). Evidence: IEA. (OMIM:300009)
- Proximal tubulopathy (HP:0000114): Dysfunction of the proximal tubule, which is the portion of the duct system of the nephron of the kidney which leads from Bowman's capsule to the loop of Henle. Evidence: IEA. (OMIM:300009)
- Thin bony cortex (HP:0002753): Abnormal thinning of the cortical region of bones. Evidence: IEA. (OMIM:300009)
- Enlargement of the ankles (HP:0003029). Evidence: IEA. (OMIM:300009)
- Bone pain (HP:0002653): An unpleasant sensation characterized by physical discomfort (such as pricking, throbbing, or aching) localized to bone. Evidence: IEA. (OMIM:300009)
- Low-molecular-weight proteinuria (HP:0003126): Excretion in urine of proteins of a size smaller than albumin (molecular weight 69 kD). Evidence: PCS. Frequency: 10/28. (PMID:8559248)
- Sparse bone trabeculae (HP:0002752). Evidence: IEA. (OMIM:300009)
- Metaphyseal irregularity (HP:0003025): Irregularity of the normally smooth surface of the metaphyses. Evidence: IEA. (OMIM:300009)
- Enlargement of the wrists (HP:0003020). Evidence: IEA. (OMIM:300009)
- Hypercalciuria (HP:0002150). Evidence: PCS. Frequency: 20/28. (PMID:8559248)
- Elevated circulating calcitriol concentration (HP:0031415): The concentration of calcitriol in the blood circulation is above the upper limit of normal. Evidence: IEA. (OMIM:300009)
- Microscopic hematuria (HP:0002907): Microscopic hematuria detected by dipstick or microscopic examination of the urine. Evidence: IEA. (OMIM:300009)
- X-linked recessive inheritance (HP:0001419): A mode of inheritance that is observed for recessive traits related to a gene encoded on the X chromosome. In the context of medical genetics, X-linked recessive disorders manifest in males (who have one copy of the X chromosome and are thus hemizygotes), but generally not in female heterozygotes who have one mutant and one normal allele. Evidence: PCS. (PMID:8559248)
- Rickets (HP:0002748): Rickets is divided into two major categories including calcipenic and phosphopenic. Hypophosphatemia is described as a common manifestation of both categories. Hypophosphatemic rickets is the most common type of rickets that is characterized by low levels of serum phosphate, resistance to ultraviolet radiation or vitamin D intake. There are several issues involved in hypophosphatemic rickets such as calcium, vitamin D, phosphorus deficiencies. Moreover, other disorder can be associated with its occurrence such as absorption defects due to pancreatic, intestinal, gastric, and renal disorders and hepatobiliary disease. Symptoms are usually seen in childhood and can be varied in severity. Severe forms may be linked to bowing of the legs, poor bone growth, and short stature as well as joint and bone pain. Hypophosphatemic rickets are associated with renal excretion of phosphate, hypophosphatemia, and mineral defects in bones. The familial type of the disease is the most common type of rickets. Evidence: IEA. (OMIM:300009)
- Osteomalacia (HP:0002749): Osteomalacia is a general term for bone weakness owing to a defect in mineralization of the protein framework known as osteoid. This defective mineralization is mainly caused by lack in vitamin D. Osteomalacia in children is known as rickets. Evidence: IEA. (OMIM:300009)
- Hypophosphatemia (HP:0002148): The concentration of phosphate ion in the blood circulation is below the lower limit of normal. Evidence: IEA. (OMIM:300009)
- Kidney stone (HP:0000787): Kidney stones (calculi) are mineral concretions in the renal calyces and pelvis that are found free or attached to the renal papillae. Evidence: PCS. Frequency: 9/28. (PMID:8559248)
These phenotypes are associated with the disease Dent disease type 1 (OMIM:300009).